- Reduced social responsiveness (HP:0012760): A reduced ability to participate in the back-and-forth flow of social interaction appropriate to culture and developmental level, which is normally characterized by an influence of the behavior of one person on the behavior of another person. This results in difficulty interacting with others through emotional, physical, or verbal communication. Evidence: TAS. (OMIM:618830)
- Global developmental delay (HP:0001263): A delay in the achievement of motor or mental milestones in the domains of development of a child, including motor skills, speech and language, cognitive skills, and social and emotional skills. This term should only be used to describe children younger than five years of age. Evidence: TAS. (OMIM:618830)
- Autistic behavior (HP:0000729): Persistent deficits in social interaction and communication and interaction as well as a markedly restricted repertoire of activity and interest as well as repetitive patterns of behavior. Evidence: TAS. (OMIM:618830)
- Compulsive behaviors (HP:0000722): Behavior that consists of repetitive acts, characterized by the feeling that one "has to" perform them, while being aware that these acts are not in line with one's overall goal. Evidence: TAS. (OMIM:618830)
- Attention deficit hyperactivity disorder (HP:0007018): Attention deficit hyperactivity disorder (ADHD) manifests at age 2-3 years or by first grade at the latest. The main symptoms are distractibility, impulsivity, hyperactivity, and often trouble organizing tasks and projects, difficulty going to sleep, and social problems from being aggressive, loud, or impatient. Evidence: TAS. (OMIM:618830)
- Autosomal dominant inheritance (HP:0000006): A mode of inheritance that is observed for traits related to a gene encoded on one of the autosomes (i.e., the human chromosomes 1-22) in which a trait manifests in heterozygotes. In the context of medical genetics, an autosomal dominant disorder is caused when a single copy of the mutant allele is present. Males and females are affected equally, and can both transmit the disorder with a risk of 50% for each child of inheriting the mutant allele. Evidence: TAS. (OMIM:618830)
These phenotypes are associated with the disease autism, susceptibility to, 20 (OMIM:618830).